Phenotypes associated with the disease cardiac arrhythmia, ankyrin-B-related (OMIM:600919):
- Atrial fibrillation (HP:0005110): An atrial arrhythmia characterized by disorganized atrial activity without discrete P waves on the surface EKG, but instead by an undulating baseline or more sharply circumscribed atrial deflections of varying amplitude an frequency ranging from 350 to 600 per minute. Evidence: TAS. (OMIM:600919)
- Prolonged QT interval (HP:0001657): Increased time between the start of the Q wave and the end of the T wave as measured by the electrocardiogram (EKG). Evidence: PCS. Frequency: 4/25. (PMID:15178757)
- Syncope (HP:0001279): A transient loss of consciousness (i.e., characterized by a rapid onset, a short duration, and a spontaneous and complete recovery) due to cerebral hypoperfusion. Evidence: PCS. Frequency: 4/25. (PMID:15178757)
- Sudden cardiac death (HP:0001645): The heart suddenly and unexpectedly stops beating resulting in death within a short time period (generally within 1 h of symptom onset). Evidence: PCS. Frequency: 3/25. (PMID:15178757)
- Autosomal dominant inheritance (HP:0000006): A mode of inheritance that is observed for traits related to a gene encoded on one of the autosomes (i.e., the human chromosomes 1-22) in which a trait manifests in heterozygotes. In the context of medical genetics, an autosomal dominant disorder is caused when a single copy of the mutant allele is present. Males and females are affected equally, and can both transmit the disorder with a risk of 50% for each child of inheriting the mutant allele. Evidence: PCS. (PMID:15178757)
- Sinus bradycardia (HP:0001688): Bradycardia related to a mean resting sinus rate of less than 50 beats per minute. Evidence: PCS. Frequency: 1/25. (PMID:15178757)